Phenotypes associated with the disease Castleman disease (ORPHA:160):
- Lymphadenopathy (HP:0002716): Enlargement (swelling) of a lymph node. Evidence: TAS. Frequency: Very frequent (HP:0040281). (ORPHA:160)
- Weight loss (HP:0001824): Reduction of total body weight. Evidence: TAS. Frequency: Frequent (HP:0040282). (ORPHA:160)
- Anemia (HP:0001903): A reduction in erythrocytes volume or hemoglobin concentration. Evidence: TAS. Frequency: Frequent (HP:0040282). (ORPHA:160)
- Abdominal pain (HP:0002027): An unpleasant sensation characterized by physical discomfort (such as pricking, throbbing, or aching) and perceived to originate in the abdomen. Evidence: TAS. Frequency: Frequent (HP:0040282). (ORPHA:160)
- Follicular hyperplasia (HP:0002729): Lymphadenopathy (enlargement of lymph nodes) owing to hyperplasia of follicular (germinal) centers. Evidence: TAS. Frequency: Frequent (HP:0040282). (ORPHA:160)
- Elevated erythrocyte sedimentation rate (HP:0003565): An increased erythrocyte sedimentation rate (ESR). The ESR is a test that measures the distance that erythrocytes have fallen after one hour in a vertical column of anticoagulated blood under the influence of gravity. The ESR is a nonspecific finding. An elevation may indicate inflammation or may be caused by any condition that elevates fibrinogen. Evidence: TAS. Frequency: Frequent (HP:0040282). (ORPHA:160)
- Elevated circulating C-reactive protein concentration (HP:0011227): The concentration of C-reactive protein in the blood circulation is above the upper limit of normal. Evidence: TAS. Frequency: Frequent (HP:0040282). (ORPHA:160)
- Fatigue (HP:0012378): A subjective feeling of tiredness characterized by a lack of energy and motivation. Evidence: TAS. Frequency: Frequent (HP:0040282). (ORPHA:160)
- Constitutional symptom (HP:0025142): A symptom or manifestation indicating a systemic or general effect of a disease and that may affect the general well-being or status of an individual. Evidence: TAS. Frequency: Frequent (HP:0040282). (ORPHA:160)
- Increased circulating interleukin 6 concentration (HP:0030783): The concentration of interleukin-6 in the blood circulation is above the upper limit of normal. Evidence: TAS. Frequency: Frequent (HP:0040282). (ORPHA:160)
- Mediastinal lymphadenopathy (HP:0100721): Swelling of lymph nodes within the mediastinum, the central compartment of the thoracic cavities that contains the heart and the great vessels, the esophagus, and trachea and other structures including lymph nodes. Evidence: TAS. Frequency: Frequent (HP:0040282). (ORPHA:160)
- Jaundice (HP:0000952): Yellow pigmentation of the skin due to bilirubin, which in turn is the result of increased bilirubin concentration in the bloodstream. Evidence: TAS. Frequency: Occasional (HP:0040283). (ORPHA:160)
- Nausea and vomiting (HP:0002017): Nausea is a commonly encountered symptom that has been defined as an unpleasant painless subjective feeling that one will imminently vomit. Vomiting has been defined as the forceful expulsion of the contents of the stomach, duodenum, or jejunum through the oral cavity. While nausea and vomiting are often thought to exist on a temporal continuum, this is not always the case. There are situations when severe nausea may be present without emesis and less frequently, when emesis may be present without preceding nausea. Evidence: TAS. Frequency: Occasional (HP:0040283). (ORPHA:160)
- Abdominal distention (HP:0003270): Distention of the abdomen. Evidence: TAS. Frequency: Occasional (HP:0040283). (ORPHA:160)
- Generalized lymphadenopathy (HP:0008940): A generalized form of lymphadenopathy. Evidence: TAS. Frequency: Occasional (HP:0040283). (ORPHA:160)
- Abnormality of the gastrointestinal tract (HP:0011024): An abnormality of the gastrointestinal tract. Evidence: TAS. Frequency: Occasional (HP:0040283). (ORPHA:160)
- Cough (HP:0012735): A sudden, audible expulsion of air from the lungs through a partially closed glottis, preceded by inhalation. Evidence: TAS. Frequency: Occasional (HP:0040283). (ORPHA:160)
- Decreased mean corpuscular volume (HP:0025066): A reduction from normal of the mean corpuscular volume, or mean cell volume (MCV) of red blood cells (usually defined as an MCV below 80 femtoliters). Evidence: TAS. Frequency: Occasional (HP:0040283). (ORPHA:160)
- Flank pain (HP:0030157): An unpleasant sensation characterized by physical discomfort (such as pricking, throbbing, or aching) and perceived to originate in the flank. Evidence: TAS. Frequency: Occasional (HP:0040283). (ORPHA:160)
- Abdominal mass (HP:0031500): An abnormal enlargement or swelling in the abdomen. Evidence: TAS. Frequency: Occasional (HP:0040283). (ORPHA:160)
- Renal insufficiency (HP:0000083): A reduction in the level of performance of the kidneys in areas of function comprising the concentration of urine, removal of wastes, the maintenance of electrolyte balance, homeostasis of blood pressure, and calcium metabolism. Evidence: TAS. Frequency: Very rare (HP:0040284). (ORPHA:160)
- Hematuria (HP:0000790): The presence of blood in the urine. Hematuria may be gross hematuria (visible to the naked eye) or microscopic hematuria (detected by dipstick or microscopic examination of the urine). Evidence: TAS. Frequency: Very rare (HP:0040284). (ORPHA:160)
- Restrictive cardiomyopathy (HP:0001723): Restrictive left ventricular physiology is characterized by a pattern of ventricular filling in which increased stiffness of the myocardium causes ventricular pressure to rise precipitously with only small increases in volume, defined as restrictive ventricular physiology in the presence of normal or reduced diastolic volumes (of one or both ventricles), normal or reduced systolic volumes, and normal ventricular wall thickness. Evidence: TAS. Frequency: Very rare (HP:0040284). (ORPHA:160)
- Thrombocytopenia (HP:0001873): A reduction in the number of circulating thrombocytes. Evidence: TAS. Frequency: Very rare (HP:0040284). (ORPHA:160)
- Dyspnea (HP:0002094): Difficult or labored breathing. Dyspnea is a subjective feeling only the patient can rate, e.g., on a Borg scale. Evidence: TAS. Frequency: Very rare (HP:0040284). (ORPHA:160)
- Intestinal obstruction (HP:0005214): Blockage or impairment of the normal flow of the contents of the intestine towards the anal canal. Evidence: TAS. Frequency: Very rare (HP:0040284). (ORPHA:160)
- Ureteral obstruction (HP:0006000): Obstruction of the flow of urine through the ureter. Evidence: TAS. Frequency: Very rare (HP:0040284). (ORPHA:160)
- Myelofibrosis (HP:0011974): Replacement of bone marrow by fibrous tissue. Evidence: TAS. Frequency: Very rare (HP:0040284). (ORPHA:160)
- Anasarca (HP:0012050): An extreme form of generalized edema with widespread and massive edema due to effusion of fluid into the extracellular space. Evidence: TAS. Frequency: Very rare (HP:0040284). (ORPHA:160)